- Anencephaly (HP:0002323): Anencephaly is a developmental anomaly characterized by a fetus that has no calvarium, with a lack of most or all of the fetus' brain tissue. Anencephaly belongs to a collective group known as neural tube defects (NTD) and is a result of the neural tube failing to close in its rostral end during fetal development. Evidence: IEA. (OMIM:207770)
- Autosomal recessive inheritance (HP:0000007): A mode of inheritance that is observed for traits related to a gene encoded on one of the autosomes (i.e., the human chromosomes 1-22) in which a trait manifests in individuals with two pathogenic alleles, either homozygotes (two copies of the same mutant allele) or compound heterozygotes (whereby each copy of a gene has a distinct mutant allele). Evidence: IEA. (OMIM:207770)
- Aprosencephaly (HP:0007268). Evidence: IEA. (OMIM:207770)
- Finger aplasia (HP:0009380): A developmental defect resulting in the presence of fewer than the normal number of fingers (i.e., aplasia of one or more fingers). Evidence: IEA. (OMIM:207770)
These phenotypes are associated with the disease XK aprosencephaly (OMIM:207770).